Phenotypes associated with the disease Hereditary hyperferritinemia-cataract syndrome (ORPHA:163):
- Cataract (HP:0000518): A cataract is an opacity or clouding that develops in the crystalline lens of the eye or in its capsule. Evidence: TAS. Frequency: Very frequent (HP:0040281). (ORPHA:163)
- Abnormality of metabolism/homeostasis (HP:0001939). Evidence: TAS. Frequency: Very frequent (HP:0040281). (ORPHA:163)